Phenotypes associated with the disease Tn polyagglutination syndrome (OMIM:300622):
- Autoimmunity (HP:0002960): The occurrence of an immune reaction against the organism's own cells or tissues. Evidence: IEA. (OMIM:300622)
- Typified by somatic mosaicism (HP:0001442): Description of conditions in which affected individuals typically display somatic mosaicism, i.e., genetically distinct populations of somatic cells in a given organism caused by DNA mutations, epigenetic alterations of DNA, chromosomal abnormalities or the spontaneous reversion of inherited mutations. In many conditions typified by somatic mosaicism, constitutive mutation is lethal and cases are exclusively or predominantly mosaic. Evidence: TAS. (OMIM:300622)
- Abnormal erythrocyte morphology (HP:0001877): Any structural abnormality of erythrocytes (red-blood cells). Evidence: IEA. (OMIM:300622)